Phenotypes associated with the disease candidiasis, familial, 4 (OMIM:613108):
- Autosomal recessive inheritance (HP:0000007): A mode of inheritance that is observed for traits related to a gene encoded on one of the autosomes (i.e., the human chromosomes 1-22) in which a trait manifests in individuals with two pathogenic alleles, either homozygotes (two copies of the same mutant allele) or compound heterozygotes (whereby each copy of a gene has a distinct mutant allele). Evidence: PCS. (PMID:19864674)
- Unusual fungal nail infection (HP:0012203): Increased susceptibility to fungal infection of the nail apparatus (onychomycosis), as manifested by recurrent or severe infection of the nail plate, nail bed, or nail matrix caused by fungal organisms. Causative agents include dermatophytes (Trichophyton species) and Candida species. Evidence: PCS. (PMID:19864674)
- Recurrent vulvovaginal candidiasis (HP:0012204): Recurrent infection involving the vulva, vagina, and adjacent crural areas, whereby the causative agent belongs to the genus Candida. Evidence: PCS. (PMID:19864674)